- Cutaneous melanoma (HP:0012056): The presence of a melanoma of the skin. Evidence: TAS. (OMIM:155755)
- Astrocytoma (HP:0009592): Astrocytoma is a neoplasm of the central nervous system derived from astrocytes. Astrocytes are a type of glial cell, and thus astrocytoma is a subtype of glioma. Evidence: TAS. (OMIM:155755)
- Autosomal dominant inheritance (HP:0000006): A mode of inheritance that is observed for traits related to a gene encoded on one of the autosomes (i.e., the human chromosomes 1-22) in which a trait manifests in heterozygotes. In the context of medical genetics, an autosomal dominant disorder is caused when a single copy of the mutant allele is present. Males and females are affected equally, and can both transmit the disorder with a risk of 50% for each child of inheriting the mutant allele. Evidence: TAS. (OMIM:155755)
These phenotypes are associated with the disease melanoma and neural system tumor syndrome (OMIM:155755).